- Thrombocytopenia (HP:0001873): A reduction in the number of circulating thrombocytes. Evidence: TAS. Frequency: Obligate (HP:0040280). (ORPHA:244242)
- Elevated circulating hepatic transaminase concentration (HP:0002910): Elevations of the levels of SGOT and SGPT in the serum. SGOT (serum glutamic oxaloacetic transaminase) and SGPT (serum glutamic pyruvic transaminase) are transaminases primarily found in the liver and heart and are released into the bloodstream as the result of liver or heart damage. SGOT and SGPT are used clinically mainly as markers of liver damage. Evidence: TAS. Frequency: Obligate (HP:0040280). (ORPHA:244242)
- Hemolytic anemia (HP:0001878): A type of anemia caused by premature destruction of red blood cells (hemolysis). Evidence: TAS. Frequency: Very frequent (HP:0040281). (ORPHA:244242)
- Proteinuria (HP:0000093): Increased levels of protein in the urine. Evidence: TAS. Frequency: Frequent (HP:0040282). (ORPHA:244242)
- Headache (HP:0002315): Cephalgia, or pain sensed in various parts of the head, not confined to the area of distribution of any nerve. Evidence: TAS. Frequency: Frequent (HP:0040282). (ORPHA:244242)
- Increased body weight (HP:0004324): Abnormally increased body weight. Evidence: TAS. Frequency: Frequent (HP:0040282). (ORPHA:244242)
- Generalized edema (HP:0007430): Generalized abnormal accumulation of fluid beneath the skin, or in one or more cavities of the body. Evidence: TAS. Frequency: Frequent (HP:0040282). (ORPHA:244242)
- Maternal hypertension (HP:0008071): Increased blood pressure during a pregnancy. Evidence: TAS. Frequency: Frequent (HP:0040282). (ORPHA:244242)
- Prolonged prothrombin time (HP:0008151): Increased time to coagulation in the prothrombin time test, which is a measure of the extrinsic pathway of coagulation. The results of the prothrombin time test are often expressed in terms of the International normalized ratio (INR), which is calculated as a ratio of the patient's prothrombin time (PT) to a control PT standardized for the potency of the thromboplastin reagent developed by the World Health Organization (WHO) using the formula: INR is equal to Patient PT divided by Control PT. Evidence: TAS. Frequency: Frequent (HP:0040282). (ORPHA:244242)
- Hypofibrinogenemia (HP:0011900): Decreased concentration of fibrinogen in the blood. Evidence: TAS. Frequency: Frequent (HP:0040282). (ORPHA:244242)
- Fatigue (HP:0012378): A subjective feeling of tiredness characterized by a lack of energy and motivation. Evidence: TAS. Frequency: Frequent (HP:0040282). (ORPHA:244242)
- Preeclampsia (HP:0100602): Pregnancy-induced hypertension in association with significant amounts of protein in the urine. Evidence: TAS. Frequency: Frequent (HP:0040282). (ORPHA:244242)
- Poor wound healing (HP:0001058): A reduced ability to heal cutaneous wounds. Evidence: TAS. Frequency: Occasional (HP:0040283). (ORPHA:244242)
- Microangiopathic hemolytic anemia (HP:0001937). Evidence: TAS. Frequency: Occasional (HP:0040283). (ORPHA:244242)
- Vomiting (HP:0002013): Forceful ejection of the contents of the stomach through the mouth by means of a series of involuntary spasmic contractions. Evidence: TAS. Frequency: Occasional (HP:0040283). (ORPHA:244242)
- Nausea (HP:0002018): A sensation of unease in the stomach together with an urge to vomit. Evidence: TAS. Frequency: Occasional (HP:0040283). (ORPHA:244242)
- Abdominal pain (HP:0002027): An unpleasant sensation characterized by physical discomfort (such as pricking, throbbing, or aching) and perceived to originate in the abdomen. Evidence: TAS. Frequency: Occasional (HP:0040283). (ORPHA:244242)
- Pleural effusion (HP:0002202): The presence of an excessive amount of fluid in the pleural cavity. Evidence: TAS. Frequency: Occasional (HP:0040283). (ORPHA:244242)
- Hypotension (HP:0002615): Low Blood Pressure, vascular hypotension. Evidence: TAS. Frequency: Occasional (HP:0040283). (ORPHA:244242)
- Back pain (HP:0003418): An unpleasant sensation characterized by physical discomfort (such as pricking, throbbing, or aching) localized to the back. Evidence: TAS. Frequency: Occasional (HP:0040283). (ORPHA:244242)
- Hemoglobinuria (HP:0003641): The presence of free hemoglobin in the urine. Evidence: TAS. Frequency: Occasional (HP:0040283). (ORPHA:244242)
- Disseminated intravascular coagulation (HP:0005521): Disseminated intravascular coagulation is characterized by the widespread activation of coagulation, which results in the intravascular formation of fibrin and ultimately thrombotic occlusion of small and midsize vessels. Evidence: TAS. Frequency: Occasional (HP:0040283). (ORPHA:244242)
- Placental abruption (HP:0011419): Separation of the placenta from the uterus wall before delivery. Evidence: TAS. Frequency: Occasional (HP:0040283). (ORPHA:244242)
- Increased circulating lactate dehydrogenase concentration (HP:0025435): An elevated level of the enzyme lactate dehydrogenase in the blood circulation. Evidence: TAS. Frequency: Occasional (HP:0040283). (ORPHA:244242)
- Decreased mean corpuscular hemoglobin concentration (HP:0025547): A reduction from the normal range of the average amount of hemoglobin per red blood cell (27 to 31 picograms/cell). A reduced mean corpuscular hemoglobin (MCH) may indicate a hypochromic anemia, but the MCH may be normal if both the total hemoglobin and the red blood cell count are reduced. Evidence: TAS. Frequency: Occasional (HP:0040283). (ORPHA:244242)
- Shoulder pain (HP:0030834): An unpleasant sensation characterized by physical discomfort (such as pricking, throbbing, or aching) localized to the shoulder. Evidence: TAS. Frequency: Occasional (HP:0040283). (ORPHA:244242)
- Pulmonary edema (HP:0100598): Fluid accumulation in the lungs. Evidence: TAS. Frequency: Occasional (HP:0040283). (ORPHA:244242)
- Eclampsia (HP:0100601): An acute and life-threatening complication of pregnancy, which is characterized by the appearance of tonic-clonic seizures, usually in a patient who had developed pre-eclampsia. Eclampsia includes seizures and coma that happen during pregnancy but are not due to preexisting or organic brain disorders. Evidence: TAS. Frequency: Occasional (HP:0040283). (ORPHA:244242)
- Epigastric pain (HP:0410019): Pain that is localized to the region of the upper abdomen immediately below the ribs. Evidence: TAS. Frequency: Occasional (HP:0040283). (ORPHA:244242)
- Cerebral hemorrhage (HP:0001342): Hemorrhage into the parenchyma of the brain. Evidence: TAS. Frequency: Very rare (HP:0040284). (ORPHA:244242)
- Acute kidney injury (HP:0001919): Sudden loss of renal function, as manifested by decreased urine production, and a rise in serum creatinine or blood urea nitrogen concentration (azotemia). Evidence: TAS. Frequency: Very rare (HP:0040284). (ORPHA:244242)
- Internal hemorrhage (HP:0011029): The presence of hemorrhage within the body. Evidence: TAS. Frequency: Very rare (HP:0040284). (ORPHA:244242)
These phenotypes are associated with the disease HELLP syndrome (ORPHA:244242).